Phenotypes associated with the disease Linear atrophoderma of Moulin (ORPHA:140933):
- Linear hyperpigmentation (HP:0007546). Evidence: TAS. Frequency: Obligate (HP:0040280). (ORPHA:140933)
Not associated with this disease:
- Pruritus (HP:0000989): Pruritus is an itch or a sensation that makes a person want to scratch. This term refers to an abnormally increased disposition to experience pruritus. Evidence: TAS. (ORPHA:140933)
- Inflammatory abnormality of the skin (HP:0011123): The presence of inflammation of the skin. That is, an abnormality of the skin resulting from the local accumulation of fluid, plasma proteins, and leukocytes. Evidence: TAS. (ORPHA:140933)
- Stiff skin (HP:0030053): An induration (hardening) of the skin. Evidence: TAS. (ORPHA:140933)
- Scleroderma (HP:0100324): A chronic autoimmune phenomenon characterized by fibrosis (or hardening) and vascular alterations of the skin. Evidence: TAS. (ORPHA:140933)